- Seizure (HP:0001250): A seizure is an intermittent abnormality of nervous system physiology characterized by a transient occurrence of signs and/or symptoms due to abnormal excessive or synchronous neuronal activity in the brain. Evidence: PCS. Frequency: 1/5. (PMID:19012874)
- Autistic behavior (HP:0000729): Persistent deficits in social interaction and communication and interaction as well as a markedly restricted repertoire of activity and interest as well as repetitive patterns of behavior. Evidence: PCS. Frequency: 1/5. (PMID:19012874)
- Autosomal dominant inheritance (HP:0000006): A mode of inheritance that is observed for traits related to a gene encoded on one of the autosomes (i.e., the human chromosomes 1-22) in which a trait manifests in heterozygotes. In the context of medical genetics, an autosomal dominant disorder is caused when a single copy of the mutant allele is present. Males and females are affected equally, and can both transmit the disorder with a risk of 50% for each child of inheriting the mutant allele. Evidence: PCS. (PMID:19012874)
- Intellectual disability (HP:0001249): The term intellectual disability or intellectual developmental disorder is used to describe significantly sub-average intellectual and adaptive functioning based on clinical assessment and as measured by individually administered, appropriately normed, standardized and validated tests of intellectual functioning and adaptive behavior, with onset during the developmental period from infancy through adolescence. Evidence: PCS. Frequency: 5/5. (PMID:19012874)
These phenotypes are associated with the disease intellectual disability, autosomal dominant 3 (OMIM:612580).